Phenotypes associated with the disease leukodystrophy, hypomyelinating, 24 (OMIM:619851):
- Peripheral axonal neuropathy (HP:0003477): An abnormality characterized by disruption of the normal functioning of peripheral axons. Evidence: PCS. Frequency: 1/1. (PMID:34403372)
- Severe short stature (HP:0003510): A severe degree of short stature, more than -4 SD from the mean corrected for age and sex. Evidence: PCS. Frequency: 1/1. (PMID:34403372)
- Typically de novo (HP:0025352): Description of conditions that are exclusively or predominantly observed to display de novo variants. In some cases, this may be due to the limited reproductive fitness of affected individuals. Evidence: PCS. (PMID:34403372)
- Cerebral atrophy (HP:0002059): Atrophy (wasting, decrease in size of cells or tissue) affecting the cerebrum. Evidence: PCS. Frequency: 1/1. (PMID:34403372)
- Microcephaly (HP:0000252): Head circumference below 2 standard deviations below the mean for age and gender. Evidence: PCS. Frequency: 1/1. (PMID:34403372)
- Decreased motor nerve conduction velocity (HP:0003431): A type of decreased nerve conduction velocity that affects the motor neuron. Evidence: PCS. Frequency: 1/1. (PMID:34403372)
- Developmental regression (HP:0002376): Loss of developmental skills, as manifested by loss of developmental milestones. Evidence: PCS. Frequency: 1/1. (PMID:34403372)
- Seizure (HP:0001250): A seizure is an intermittent abnormality of nervous system physiology characterized by a transient occurrence of signs and/or symptoms due to abnormal excessive or synchronous neuronal activity in the brain. Evidence: PCS. Frequency: 1/1. (PMID:34403372)
- Flexion contracture (HP:0001371): A flexion contracture is a bent (flexed) joint that cannot be straightened actively or passively. It is thus a chronic loss of joint motion due to structural changes in muscle, tendons, ligaments, or skin that prevents normal movement of joints. Evidence: PCS. Frequency: 1/1. (PMID:34403372)
- Global developmental delay (HP:0001263): A delay in the achievement of motor or mental milestones in the domains of development of a child, including motor skills, speech and language, cognitive skills, and social and emotional skills. This term should only be used to describe children younger than five years of age. Evidence: PCS. Frequency: 1/1. (PMID:34403372)
- Areflexia (HP:0001284): Absence of neurologic reflexes such as the knee-jerk reaction. Evidence: PCS. Frequency: 1/1. (PMID:34403372)
- Widened subarachnoid space (HP:0012704): An increase in size of the anatomic space between the arachnoid membrane and pia mater. Evidence: PCS. Frequency: 1/1. (PMID:34403372)
- Decreased total B cell count (HP:0010976): The absolute number of B cells in the blood, per microlitre is below the lower limit of normal of the reference range for the appropriate sex and age-group. Evidence: PCS. Frequency: 1/1. (PMID:34403372)
- Thin corpus callosum (HP:0033725): An abnormally thin corpus callous, due to atrophy, hypoplasia or agenesis. This term is intended to be used in situations where it is not known if thinning of the corpus callosum (for instance, as visualized by magnetic resonance tomography) is due to abnormal development (e.g. a leukodystrophy) or atrophy following normal development (e.g. neurodegeneration). Evidence: PCS. Frequency: 1/1. (PMID:34403372)
- Cataract (HP:0000518): A cataract is an opacity or clouding that develops in the crystalline lens of the eye or in its capsule. Evidence: PCS. Frequency: 1/1. (PMID:34403372)
- Hypothyroidism (HP:0000821): Deficiency of thyroid hormone. Evidence: PCS. Frequency: 1/1. (PMID:34403372)
- Tongue fasciculations (HP:0001308): Fasciculations or fibrillation affecting the tongue muscle. Evidence: PCS. Frequency: 1/1. (PMID:34403372)
- Ventriculomegaly (HP:0002119): An increase in size of the ventricular system of the brain. Evidence: PCS. Frequency: 1/1. (PMID:34403372)
- Leukodystrophy (HP:0002415): Leukodystrophy refers to deterioration of white matter of the brain resulting from degeneration of myelin sheaths in the CNS. Their basic defect is directly related to the synthesis and maintenance of myelin membranes. Symmetric white matter involvement at MRI is a typical finding in patients with leukodystrophies. Evidence: PCS. Frequency: 1/1. (PMID:34403372)
- Neonatal onset (HP:0003623): Onset of signs or symptoms of disease within the first 28 days of life. Evidence: PCS. Frequency: 1/1. (PMID:34403372)